Phenotypes associated with the disease intellectual developmental disorder 62 (OMIM:618793):
- Arachnodactyly (HP:0001166): Abnormally long and slender fingers (spider fingers). Evidence: PCS. (PMID:29460436)
- Strabismus (HP:0000486): A misalignment of the eyes so that the visual axes deviate from bifoveal fixation. The classification of strabismus may be based on a number of features including the relative position of the eyes, whether the deviation is latent or manifest, intermittent or constant, concomitant or otherwise and according to the age of onset and the relevance of any associated refractive error. Evidence: PCS. Frequency: 2/3. (PMID:29460436)
- Scoliosis (HP:0002650): The presence of an abnormal lateral curvature of the spine. Evidence: PCS. Frequency: 3/3. (PMID:29460436)
- Seizure (HP:0001250): A seizure is an intermittent abnormality of nervous system physiology characterized by a transient occurrence of signs and/or symptoms due to abnormal excessive or synchronous neuronal activity in the brain. Evidence: PCS. Frequency: 1/3. (PMID:29460436)
- Joint hypermobility (HP:0001382): The capability that a joint (or a group of joints) has to move, passively and/or actively, beyond normal limits along physiological axes. Evidence: PCS. Frequency: 1/3. (PMID:29460436)
- Striae distensae (HP:0001065): Thinned, erythematous, depressed bands of atrophic skin. Initially, striae appear as flattened and thinned, pinkish linear regions of the skin. Striae tend to enlarge in length and become reddish or purplish. Later, striae tend to appear as white, depressed bands that are parallel to the lines of skin tension. Striae distensae occur most often in areas that have been subject to distension such as the lower back, buttocks, thighs, breast, abdomen, and shoulders. Evidence: PCS. Frequency: 1/3. (PMID:29460436)
- Infantile onset (HP:0003593): Onset of signs or symptoms of disease between 28 days to one year of life. Evidence: PCS. (PMID:29460436)
- Increased arm span (HP:0012771): Increased length of the arm span (length from one end of an individual's arms measured at the fingertips to the other when raised parallel to the ground at shoulder height at a one-hundred eighty degree angle). Evidence: PCS. Frequency: 1/3. (PMID:29460436)
- Disproportionate tall stature (HP:0001519): A tall and slim body build with increased arm span to height ratio (>1.05) and a reduced upper-to-lower segment ratio (<0.85), i.e., unusually long arms and legs. The extremities as well as the hands and feet are unusually slim. Evidence: PCS. Frequency: 1/3. (PMID:29460436)
- Autistic behavior (HP:0000729): Persistent deficits in social interaction and communication and interaction as well as a markedly restricted repertoire of activity and interest as well as repetitive patterns of behavior. Evidence: PCS. Frequency: 1/3. (PMID:29460436)
- Pes planus (HP:0001763): A foot where the longitudinal arch of the foot is in contact with the ground or floor when the individual is standing; or, in a patient lying supine, a foot where the arch is in contact with the surface of a flat board pressed against the sole of the foot by the examiner with a pressure similar to that expected from weight bearing; or, the height of the arch is reduced. Evidence: PCS. Frequency: 1/3. (PMID:29460436)
- Autosomal dominant inheritance (HP:0000006): A mode of inheritance that is observed for traits related to a gene encoded on one of the autosomes (i.e., the human chromosomes 1-22) in which a trait manifests in heterozygotes. In the context of medical genetics, an autosomal dominant disorder is caused when a single copy of the mutant allele is present. Males and females are affected equally, and can both transmit the disorder with a risk of 50% for each child of inheriting the mutant allele. Evidence: PCS. (PMID:29460436)
- Intellectual disability (HP:0001249): The term intellectual disability or intellectual developmental disorder is used to describe significantly sub-average intellectual and adaptive functioning based on clinical assessment and as measured by individually administered, appropriately normed, standardized and validated tests of intellectual functioning and adaptive behavior, with onset during the developmental period from infancy through adolescence. Evidence: PCS. Frequency: 3/3. (PMID:29460436)
- Cerebellar vermis atrophy (HP:0006855): Wasting (atrophy) of the vermis of cerebellum. Evidence: PCS. Frequency: 1/3. (PMID:29460436)